- Bruising susceptibility (HP:0000978, a Human Phenotype Ontology term): An ecchymosis (bruise) refers to the skin discoloration caused by the escape of blood into the tissues from ruptured blood vessels. This term refers to an abnormally increased susceptibility to bruising. The corresponding phenotypic abnormality is generally elicited on medical history as a report of frequent ecchymoses or bruising without adequate trauma. Evidence: TAS. Frequency: Very frequent (HP:0040281, a Human Phenotype Ontology term). (ORPHA:177926)
- Reduced factor VIII activity (HP:0003125, a Human Phenotype Ontology term): Reduced activity of coagulation factor VIII. Factor VIII (fVIII) is a cofactor in the intrinsic clotting cascade that is activated to fVIIIa in the presence of minute quantities of thrombin. fVIIIa acts as a receptor, for factors IXa and X. Evidence: TAS. Frequency: Very frequent (HP:0040281, a Human Phenotype Ontology term). (ORPHA:177926)
- Menorrhagia (HP:0000132, a Human Phenotype Ontology term): Prolonged and excessive menses at regular intervals in excess of 80 mL or lasting longer than 7 days. Evidence: TAS. Frequency: Frequent (HP:0040282, a Human Phenotype Ontology term). (ORPHA:177926)
- Epistaxis (HP:0000421, a Human Phenotype Ontology term): Epistaxis, or nosebleed, refers to a hemorrhage localized in the nose. Evidence: TAS. Frequency: Frequent (HP:0040282, a Human Phenotype Ontology term). (ORPHA:177926)
- Abnormal bleeding (HP:0001892, a Human Phenotype Ontology term): An abnormal susceptibility to bleeding, often referred to as a bleeding diathesis. A bleeding diathesis may be related to vascular, platelet and coagulation defects. Evidence: TAS. Frequency: Frequent (HP:0040282, a Human Phenotype Ontology term). (ORPHA:177926)
- Prolonged bleeding after surgery (HP:0004846, a Human Phenotype Ontology term): Bleeding that persists longer than the normal time following a surgical procedure. Evidence: TAS. Frequency: Frequent (HP:0040282, a Human Phenotype Ontology term). (ORPHA:177926)
- Prolonged bleeding after dental extraction (HP:0006298, a Human Phenotype Ontology term): Prolonged bleeding post dental extraction sufficient to require medical intervention. Evidence: TAS. Frequency: Frequent (HP:0040282, a Human Phenotype Ontology term). (ORPHA:177926)
- Prolonged bleeding following procedure (HP:0011890, a Human Phenotype Ontology term): Prolonged or protracted bleeding following an invasive procedure or intervention. Evidence: TAS. Frequency: Frequent (HP:0040282, a Human Phenotype Ontology term). (ORPHA:177926)
- Post-partum hemorrhage (HP:0011891, a Human Phenotype Ontology term): Significant maternal hemorrhage/blood loss following deilvery of a child. Evidence: TAS. Frequency: Frequent (HP:0040282, a Human Phenotype Ontology term). (ORPHA:177926)
- Prolonged partial thromboplastin time (HP:0003645, a Human Phenotype Ontology term): Increased time to coagulation in the partial thromboplastin time (PTT) test, a measure of the intrinsic and common coagulation pathways. Phospholipid, and activator, and calcium are mixed into an anticoagulated plasma sample, and the time is measured until a thrombus forms. Evidence: TAS. Frequency: Occasional (HP:0040283, a Human Phenotype Ontology term). (ORPHA:177926)
- Joint hemorrhage (HP:0005261, a Human Phenotype Ontology term): Hemorrhage occurring within a joint. Evidence: TAS. Frequency: Occasional (HP:0040283, a Human Phenotype Ontology term). (ORPHA:177926)
- Spontaneous hematomas (HP:0007420, a Human Phenotype Ontology term): Spontaneous development of hematomas (hematoma) or bruises without significant trauma. Evidence: TAS. Frequency: Very rare (HP:0040284, a Human Phenotype Ontology term). (ORPHA:177926)
These phenotypes are associated with the disease Bleeding disorder in hemophilia A carriers (ORPHA:177926, an Orphanet rare-disease identifier).